Phenotypes associated with the disease Autosomal dominant popliteal pterygium syndrome (ORPHA:1300):
- Cryptorchidism (HP:0000028): Testis in inguinal canal. That is, absence of one or both testes from the scrotum owing to failure of the testis or testes to descend through the inguinal canal to the scrotum. Evidence: TAS. Frequency: Frequent (HP:0040282). (ORPHA:1300)
- Small scrotum (HP:0000046): Apparently small scrotum for age. Evidence: TAS. Frequency: Frequent (HP:0040282). (ORPHA:1300)
- Bifid scrotum (HP:0000048): Midline indentation or cleft of the scrotum. Evidence: TAS. Frequency: Frequent (HP:0040282). (ORPHA:1300)
- Hypoplastic labia majora (HP:0000059): Undergrowth of the outer labia. Evidence: TAS. Frequency: Frequent (HP:0040282). (ORPHA:1300)
- Ambiguous genitalia (HP:0000062): A genital phenotype that is not clearly assignable to a single gender. Ambiguous genitalia can be evaluated using the Prader scale: Prader 0: Normal female external genitalia. Prader 1: Female external genitalia with clitoromegaly. Prader 2: Clitoromegaly with partial labial fusion forming a funnel-shaped urogenital sinus. Prader 3: Increased phallic enlargement. Complete labioscrotal fusion forming a urogenital sinus with a single opening. Prader 4: Complete scrotal fusion with urogenital opening at the base or on the shaft of the phallus. Prader 5: Normal male external genitalia. The diagnosis of ambiguous genitalia is made for Prader 1-4. Evidence: TAS. Frequency: Occasional (HP:0040283). (ORPHA:1300)
- Cleft palate (HP:0000175): Cleft palate is a developmental defect of the palate resulting from a failure of fusion of the palatine processes and manifesting as a separation of the roof of the mouth (soft and hard palate). Evidence: TAS. Frequency: Very frequent (HP:0040281). (ORPHA:1300)
- Thin upper lip vermilion (HP:0000219): Height of the vermilion of the upper lip in the midline more than 2 SD below the mean. Alternatively, an apparently reduced height of the vermilion of the upper lip in the frontal view (subjective). Evidence: TAS. Frequency: Very frequent (HP:0040281). (ORPHA:1300)
- Micrognathia (HP:0000347): Developmental hypoplasia of the mandible. Evidence: TAS. Frequency: Very frequent (HP:0040281). (ORPHA:1300)
- Choanal atresia (HP:0000453): Absence or abnormal closure of the choana (the posterior nasal aperture). Most embryologists believe that posterior choanal atresia results from a failure of rupture between the 35th and 38th day of fetal life of the partition which separates the bucconasal or buccopharyngeal membranes. The resultant choanal atresia may be unilateral or bilateral, bony or membranous, complete or incomplete. In over 90 per cent of cases the obstruction is bony, while in the remainder it is membranous. The bony type of atresia is commonly located 1-2 mm. anterior to the posterior edge of the hard palate, and the osseous septum varies in thickness from 1 to 10 mm. In the membranous form of choanal atresia the obstruction usually occurs further posteriorly. In approximately one third of cases the atresia is bilateral. Evidence: TAS. Frequency: Occasional (HP:0040283). (ORPHA:1300)
- Abnormal rib morphology (HP:0000772): An anomaly of the rib. Evidence: TAS. Frequency: Frequent (HP:0040282). (ORPHA:1300)
- Split hand (HP:0001171): A condition in which middle parts of the hand (fingers and metacarpals) are missing giving a cleft appearance. The severity is very variable ranging from slightly hypoplastic middle fingers over absent middle fingers as far as oligo- or monodactyl hands. Evidence: TAS. Frequency: Occasional (HP:0040283). (ORPHA:1300)
- Specific learning disability (HP:0001328): Impairment of certain skills such as reading or writing, coordination, self-control, or attention that interfere with the ability to learn. The impairment is not related to a global deficiency of intelligence. Evidence: TAS. Frequency: Occasional (HP:0040283). (ORPHA:1300)
- Joint stiffness (HP:0001387): Joint stiffness is a perceived sensation of tightness in a joint or joints when attempting to move them after a period of inactivity. Joint stiffness typically subsides over time. Evidence: TAS. Frequency: Very frequent (HP:0040281). (ORPHA:1300)
- Abnormal nail morphology (HP:0001597): Abnormal structure or appearance of the nail. Evidence: TAS. Frequency: Frequent (HP:0040282). (ORPHA:1300)
- Toe syndactyly (HP:0001770): Webbing or fusion of the toes, involving soft parts only or including bone structure. Bony fusions are referred to as "bony" Syndactyly if the fusion occurs in a radio-ulnar axis. Fusions of bones of the toes in a proximo-distal axis are referred to as "Symphalangism". Evidence: TAS. Frequency: Very frequent (HP:0040281). (ORPHA:1300)
- Generalized hirsutism (HP:0002230): Abnormally increased hair growth over much of the entire body. Evidence: TAS. Frequency: Very frequent (HP:0040281). (ORPHA:1300)
- Scoliosis (HP:0002650): The presence of an abnormal lateral curvature of the spine. Evidence: TAS. Frequency: Frequent (HP:0040282). (ORPHA:1300)
- Finger syndactyly (HP:0006101): Webbing or fusion of the fingers, involving soft parts only or including bone structure. Bony fusions are referred to as "bony" Syndactyly if the fusion occurs in a radio-ulnar axis. Fusions of bones of the fingers in a proximo-distal axis are referred to as "Symphalangism". Evidence: TAS. Frequency: Frequent (HP:0040282). (ORPHA:1300)
- Nonketotic hyperglycinemia (HP:0008288). Evidence: TAS. Frequency: Frequent (HP:0040282). (ORPHA:1300)
- Fibrous syngnathia (HP:0009754): Complete or nearly complete soft tissue fusion of the alveolar ridges. Evidence: TAS. Frequency: Frequent (HP:0040282). (ORPHA:1300)
- Ankyloblepharon (HP:0009755): Partial fusion of the upper and lower eyelid margins by single or multiple bands of tissue. Evidence: TAS. Frequency: Frequent (HP:0040282). (ORPHA:1300)
- Popliteal pterygium (HP:0009756): A pterygium (or pterygia) occurring in the popliteal region (the back of the knee). Evidence: TAS. Frequency: Frequent (HP:0040282). (ORPHA:1300)
- Lip pit (HP:0100267): A depression located on a lip. Evidence: TAS. Frequency: Frequent (HP:0040282). (ORPHA:1300)
- Non-midline cleft of the upper lip (HP:0100335): Clefting (gap or groove) of the upper lip affecting the lateral portions of the upper lip rather than the midline/median region. Evidence: TAS. Frequency: Frequent (HP:0040282). (ORPHA:1300)